- Sensorineural hearing impairment (HP:0000407): A type of hearing impairment in one or both ears related to an abnormal functionality of the cochlear nerve. Evidence: TAS. (OMIM:600792)
- Autosomal recessive inheritance (HP:0000007): A mode of inheritance that is observed for traits related to a gene encoded on one of the autosomes (i.e., the human chromosomes 1-22) in which a trait manifests in individuals with two pathogenic alleles, either homozygotes (two copies of the same mutant allele) or compound heterozygotes (whereby each copy of a gene has a distinct mutant allele). Evidence: TAS. (OMIM:600792)
These phenotypes are associated with the disease autosomal recessive nonsyndromic hearing loss 5 (OMIM:600792).